Phenotypes associated with the disease yellow nail syndrome (OMIM:153300):
- Slow-growing nails (HP:0008383): Nails whose growth is slower than normal. Evidence: IEA. (OMIM:153300)
- Predominantly lower limb lymphedema (HP:0003550): Localized fluid retention and tissue swelling caused by a compromised lymphatic system, affecting mainly the legs. Evidence: IEA. (OMIM:153300)
- Yellow nails (HP:0011367): Yellowish discoloration of the nails. Evidence: TAS. (OMIM:153300)
- Hypoplasia of lymphatic vessels (HP:0003759): Congenital underdevelopment of lymph vessels. Evidence: TAS. (OMIM:153300)
- Lymphedema (HP:0001004): Localized fluid retention and tissue swelling caused by a compromised lymphatic system. Evidence: TAS. (OMIM:153300)
- Autosomal dominant inheritance (HP:0000006): A mode of inheritance that is observed for traits related to a gene encoded on one of the autosomes (i.e., the human chromosomes 1-22) in which a trait manifests in heterozygotes. In the context of medical genetics, an autosomal dominant disorder is caused when a single copy of the mutant allele is present. Males and females are affected equally, and can both transmit the disorder with a risk of 50% for each child of inheriting the mutant allele. Evidence: IEA. (OMIM:153300)